Phenotypes associated with the disease Inhalational botulism (ORPHA:254504, an Orphanet rare-disease identifier):
- Urinary retention (HP:0000016, a Human Phenotype Ontology term): Inability to completely empty the urinary bladder during the process of urination. Evidence: TAS. Frequency: Very frequent (HP:0040281, a Human Phenotype Ontology term). (ORPHA:254504)
- Xerostomia (HP:0000217, a Human Phenotype Ontology term): Dryness of the mouth due to salivary gland dysfunction. Evidence: TAS. Frequency: Very frequent (HP:0040281, a Human Phenotype Ontology term). (ORPHA:254504)
- Ptosis (HP:0000508, a Human Phenotype Ontology term): The upper eyelid margin is positioned 3 mm or more lower than usual and covers the superior portion of the iris (objective); or, the upper lid margin obscures at least part of the pupil (subjective). Evidence: TAS. Frequency: Very frequent (HP:0040281, a Human Phenotype Ontology term). (ORPHA:254504)
- Diplopia (HP:0000651, a Human Phenotype Ontology term): Diplopia is a condition in which a single object is perceived as two images, it is also known as double vision. Evidence: TAS. Frequency: Very frequent (HP:0040281, a Human Phenotype Ontology term). (ORPHA:254504)
- Muscle weakness (HP:0001324, a Human Phenotype Ontology term): Reduced strength of muscles. Evidence: TAS. Frequency: Very frequent (HP:0040281, a Human Phenotype Ontology term). (ORPHA:254504)
- Diarrhea (HP:0002014, a Human Phenotype Ontology term): Abnormally increased frequency (usually defined as three or more) loose or watery bowel movements a day. Evidence: TAS. Frequency: Frequent (HP:0040282, a Human Phenotype Ontology term). (ORPHA:254504)
- Nausea and vomiting (HP:0002017, a Human Phenotype Ontology term): Nausea is a commonly encountered symptom that has been defined as an unpleasant painless subjective feeling that one will imminently vomit. Vomiting has been defined as the forceful expulsion of the contents of the stomach, duodenum, or jejunum through the oral cavity. While nausea and vomiting are often thought to exist on a temporal continuum, this is not always the case. There are situations when severe nausea may be present without emesis and less frequently, when emesis may be present without preceding nausea. Evidence: TAS. Frequency: Frequent (HP:0040282, a Human Phenotype Ontology term). (ORPHA:254504)
- Constipation (HP:0002019, a Human Phenotype Ontology term): Infrequent or difficult evacuation of feces. Evidence: TAS. Frequency: Very frequent (HP:0040281, a Human Phenotype Ontology term). (ORPHA:254504)
- Dyspnea (HP:0002094, a Human Phenotype Ontology term): Difficult or labored breathing. Dyspnea is a subjective feeling only the patient can rate, e.g., on a Borg scale. Evidence: TAS. Frequency: Frequent (HP:0040282, a Human Phenotype Ontology term). (ORPHA:254504)
- Paralysis (HP:0003470, a Human Phenotype Ontology term): Paralysis of voluntary muscles means loss of contraction due to interruption of one or more motor pathways from the brain to the muscle fibers. Although the word paralysis is often used interchangeably to mean either complete or partial loss of muscle strength, it is preferable to use paralysis or plegia for complete or severe loss of muscle strength, and paresis for partial or slight loss. Motor paralysis results from deficits of the upper motor neurons (corticospinal, corticobulbar, or subcorticospinal). Motor paralysis is often accompanied by an impairment in the facility of movement. Evidence: TAS. Frequency: Very frequent (HP:0040281, a Human Phenotype Ontology term). (ORPHA:254504)
- Cranial nerve paralysis (HP:0006824, a Human Phenotype Ontology term). Evidence: TAS. Frequency: Very frequent (HP:0040281, a Human Phenotype Ontology term). (ORPHA:254504)
- Mydriasis (HP:0011499, a Human Phenotype Ontology term): Abnormal dilatation of the iris. Evidence: TAS. Frequency: Very frequent (HP:0040281, a Human Phenotype Ontology term). (ORPHA:254504)
- Fatigue (HP:0012378, a Human Phenotype Ontology term): A subjective feeling of tiredness characterized by a lack of energy and motivation. Evidence: TAS. Frequency: Very frequent (HP:0040281, a Human Phenotype Ontology term). (ORPHA:254504)